Phenotypes associated with the disease otosclerosis 1 (OMIM:166800):
- Otosclerosis (HP:0000362): In otosclerosis, a callus of bone accumulates on the stapes creating a partial fixation. This limits the movement of the stapes bone, which results in hearing loss. Evidence: IEA. (OMIM:166800)
- Conductive hearing impairment (HP:0000405): An abnormality of vibrational conductance of sound to the inner ear leading to impairment of sensory perception of sound. Evidence: IEA. (OMIM:166800)
- Autosomal dominant inheritance (HP:0000006): A mode of inheritance that is observed for traits related to a gene encoded on one of the autosomes (i.e., the human chromosomes 1-22) in which a trait manifests in heterozygotes. In the context of medical genetics, an autosomal dominant disorder is caused when a single copy of the mutant allele is present. Males and females are affected equally, and can both transmit the disorder with a risk of 50% for each child of inheriting the mutant allele. Evidence: IEA. (OMIM:166800)